Phenotypes associated with the disease muscular dystrophy, pseudohypertrophic, with Internalized capillaries (OMIM:159050):
- Muscular dystrophy (HP:0003560): The term dystrophy means abnormal growth. However, muscular dystrophy is used to describe primary myopathies with a genetic basis and a progressive course characterized by progressive skeletal muscle weakness and wasting, defects in muscle proteins, and histological features of muscle fiber degeneration (necrosis) and regeneration. If possible, it is preferred to use other HPO terms to describe the precise phenotypic abnormalities. Evidence: TAS. (OMIM:159050)
- Central core regions in muscle fibers (HP:0030230): The presence of disorganized areas called cores in the center of muscle fibers. There is a typical appearance of the biopsy on light microscopy, where the muscle cells have cores that are devoid of mitochondria and specific enzymes. Cores are typically well demarcated and centrally located, but may occasionally be multiple and of eccentric. Evidence: TAS. (OMIM:159050)
- Muscle weakness (HP:0001324): Reduced strength of muscles. Evidence: IEA. (OMIM:159050)
- Autosomal dominant inheritance (HP:0000006): A mode of inheritance that is observed for traits related to a gene encoded on one of the autosomes (i.e., the human chromosomes 1-22) in which a trait manifests in heterozygotes. In the context of medical genetics, an autosomal dominant disorder is caused when a single copy of the mutant allele is present. Males and females are affected equally, and can both transmit the disorder with a risk of 50% for each child of inheriting the mutant allele. Evidence: IEA. (OMIM:159050)